- Autosomal recessive inheritance (HP:0000007): A mode of inheritance that is observed for traits related to a gene encoded on one of the autosomes (i.e., the human chromosomes 1-22) in which a trait manifests in individuals with two pathogenic alleles, either homozygotes (two copies of the same mutant allele) or compound heterozygotes (whereby each copy of a gene has a distinct mutant allele). Evidence: TAS. (OMIM:612076)
- Hypouricemia (HP:0003537): The concentration of uric acid in the blood circulation is below the lower limit of normal. Evidence: PCS. (PMID:19026395)
- Autosomal dominant inheritance (HP:0000006): A mode of inheritance that is observed for traits related to a gene encoded on one of the autosomes (i.e., the human chromosomes 1-22) in which a trait manifests in heterozygotes. In the context of medical genetics, an autosomal dominant disorder is caused when a single copy of the mutant allele is present. Males and females are affected equally, and can both transmit the disorder with a risk of 50% for each child of inheriting the mutant allele. Evidence: PCS. (PMID:19026395)
- Kidney stone (HP:0000787): Kidney stones (calculi) are mineral concretions in the renal calyces and pelvis that are found free or attached to the renal papillae. Evidence: TAS. Frequency: Occasional (HP:0040283). (OMIM:612076)
These phenotypes are associated with the disease hypouricemia, renal, 2 (OMIM:612076).